- Hypospadias (HP:0000047): Abnormal position of urethral meatus on the ventral penile shaft (underside) characterized by displacement of the urethral meatus from the tip of the glans penis to the ventral surface of the penis, scrotum, or perineum. Evidence: TAS. Frequency: Occasional (HP:0040283). (ORPHA:1784)
- Bifid scrotum (HP:0000048): Midline indentation or cleft of the scrotum. Evidence: TAS. Frequency: Occasional (HP:0040283). (ORPHA:1784)
- Abnormality of the genitourinary system (HP:0000119): The presence of any abnormality of the genitourinary system. Evidence: TAS. Frequency: Occasional (HP:0040283). (ORPHA:1784)
- Cleft palate (HP:0000175): Cleft palate is a developmental defect of the palate resulting from a failure of fusion of the palatine processes and manifesting as a separation of the roof of the mouth (soft and hard palate). Evidence: TAS. Frequency: Very frequent (HP:0040281). (ORPHA:1784)
- High palate (HP:0000218): Height of the palate more than 2 SD above the mean (objective) or palatal height at the level of the first permanent molar more than twice the height of the teeth (subjective). Evidence: TAS. Frequency: Very frequent (HP:0040281). (ORPHA:1784)
- Everted lower lip vermilion (HP:0000232): An abnormal configuration of the lower lip such that it is turned outward i.e., everted, with the Inner aspect of the lower lip vermilion (normally opposing the teeth) being visible in a frontal view. Evidence: TAS. Frequency: Frequent (HP:0040282). (ORPHA:1784)
- Brachycephaly (HP:0000248): An abnormality of skull shape characterized by a decreased anterior-posterior diameter. That is, a cephalic index greater than 81%. Alternatively, an apparently shortened anteroposterior dimension (length) of the head compared to width. Evidence: TAS. Frequency: Very frequent (HP:0040281). (ORPHA:1784)
- Hypertelorism (HP:0000316): Interpupillary distance more than 2 SD above the mean (alternatively, the appearance of an increased interpupillary distance or widely spaced eyes). Evidence: TAS. Frequency: Very frequent (HP:0040281). (ORPHA:1784)
- Broad forehead (HP:0000337): Width of the forehead or distance between the frontotemporales is more than two standard deviations above the mean (objective); or apparently increased distance between the two sides of the forehead. Evidence: TAS. Frequency: Very frequent (HP:0040281). (ORPHA:1784)
- Broad nasal tip (HP:0000455): Increase in width of the nasal tip. Evidence: TAS. Frequency: Very frequent (HP:0040281). (ORPHA:1784)
- Downslanted palpebral fissures (HP:0000494): The palpebral fissure inclination is more than two standard deviations below the mean. Evidence: TAS. Frequency: Very frequent (HP:0040281). (ORPHA:1784)
- Ptosis (HP:0000508): The upper eyelid margin is positioned 3 mm or more lower than usual and covers the superior portion of the iris (objective); or, the upper lid margin obscures at least part of the pupil (subjective). Evidence: TAS. Frequency: Very frequent (HP:0040281). (ORPHA:1784)
- Eyelid coloboma (HP:0000625): A short discontinuity of the margin of the lower or upper eyelid. Evidence: TAS. Frequency: Very frequent (HP:0040281). (ORPHA:1784)
- Hypopigmented skin patches (HP:0001053). Evidence: TAS. Frequency: Very frequent (HP:0040281). (ORPHA:1784)
- Brushfield spots (HP:0001088): The presence of whitish spots in a ring-like arrangement at the periphery of the iris. Evidence: TAS. Frequency: Very frequent (HP:0040281). (ORPHA:1784)
- Brachydactyly (HP:0001156): Digits that appear disproportionately short compared to the hand/foot. The word brachydactyly is used here to describe a series distinct patterns of shortened digits (brachydactyly types A-E). This is the sense used here. Evidence: TAS. Frequency: Very frequent (HP:0040281). (ORPHA:1784)
- Anonychia (HP:0001798): Aplasia of the nail. Evidence: TAS. Frequency: Very frequent (HP:0040281). (ORPHA:1784)
- Cerebral cortical atrophy (HP:0002120): Atrophy of the cortex of the cerebrum. Evidence: TAS. Frequency: Very frequent (HP:0040281). (ORPHA:1784)
- Micromelia (HP:0002983): The presence of abnormally small extremities. Evidence: TAS. Frequency: Very frequent (HP:0040281). (ORPHA:1784)
- Dimple on nasal tip (HP:0004132): An abnormal indentation of the skin in the region of the nasal tip. Evidence: TAS. Frequency: Very frequent (HP:0040281). (ORPHA:1784)
- Short stature (HP:0004322): A height below that which is expected according to age and gender norms. Although there is no universally accepted definition of short stature, many refer to "short stature" as height more than 2 standard deviations below the mean for age and gender (or below the 3rd percentile for age and gender dependent norms). Evidence: TAS. Frequency: Very frequent (HP:0040281). (ORPHA:1784)
- Abnormal epiphysis morphology (HP:0005930): An anomaly of epiphysis, which is the expanded articular end of a long bone that developes from a secondary ossification center, and which during the period of growth is either entirely cartilaginous or is separated from the shaft by a cartilaginous disk. Evidence: TAS. Frequency: Very frequent (HP:0040281). (ORPHA:1784)
- Short distal phalanx of finger (HP:0009882): Short distance from the end of the finger to the most distal interphalangeal crease or the distal interphalangeal joint flexion point. That is, hypoplasia of one or more of the distal phalanx of finger. Evidence: TAS. Frequency: Very frequent (HP:0040281). (ORPHA:1784)
- Severe intellectual disability (HP:0010864): Severe intellectual disability (ID) is defined as a type of ID characterized by severely sub-average adaptive functioning and intellectual functioning, with an intelligence quotient (IQ) the range of 20-34. Evidence: TAS. Frequency: Very frequent (HP:0040281). (ORPHA:1784)
- Broad thumb (HP:0011304): Increased thumb width without increased dorso-ventral dimension. Evidence: TAS. Frequency: Very frequent (HP:0040281). (ORPHA:1784)
- Midface retrusion (HP:0011800): Posterior positions and/or vertical shortening of the infraorbital and perialar regions, or increased concavity of the face and/or reduced nasolabial angle. Evidence: TAS. Frequency: Very frequent (HP:0040281). (ORPHA:1784)
- Non-midline cleft of the upper lip (HP:0100335): Clefting (gap or groove) of the upper lip affecting the lateral portions of the upper lip rather than the midline/median region. Evidence: TAS. Frequency: Very frequent (HP:0040281). (ORPHA:1784)
- Camptodactyly of finger (HP:0100490): The distal interphalangeal joint and/or the proximal interphalangeal joint of the fingers cannot be extended to 180 degrees by either active or passive extension. Evidence: TAS. Frequency: Very frequent (HP:0040281). (ORPHA:1784)
- Aplasia/Hypoplasia of the eyebrow (HP:0100840): Absence or underdevelopment of the eyebrow. Evidence: TAS. Frequency: Very frequent (HP:0040281). (ORPHA:1784)
These phenotypes are associated with the disease Acrofrontofacionasal dysostosis (ORPHA:1784).